- Autism (HP:0000717): Autism is a neurodevelopmental disorder characterized by impaired social interaction and communication, and by restricted and repetitive behavior. Autism begins in childhood. It is marked by the presence of markedly abnormal or impaired development in social interaction and communication and a markedly restricted repertoire of activity and interest. Manifestations of the disorder vary greatly depending on the developmental level and chronological age of the individual (DSM-IV). Evidence: IEA. (OMIM:238350)
- Autosomal recessive inheritance (HP:0000007): A mode of inheritance that is observed for traits related to a gene encoded on one of the autosomes (i.e., the human chromosomes 1-22) in which a trait manifests in individuals with two pathogenic alleles, either homozygotes (two copies of the same mutant allele) or compound heterozygotes (whereby each copy of a gene has a distinct mutant allele). Evidence: IEA. (OMIM:238350)
- Non-Mendelian inheritance (HP:0001426): A mode of inheritance that depends on genetic determinants in more than one gene. Evidence: IEA. (OMIM:238350)
- Sporadic (HP:0003745): Cases of the disease in question occur without a previous family history, i.e., as isolated cases without being transmitted from a parent and without other siblings being affected. Evidence: IEA. (OMIM:238350)
These phenotypes are associated with the disease hyperlexia (OMIM:238350).